Phenotypes associated with the disease acute promyelocytic leukemia (OMIM:612376):
- Abnormal granulocytopoietic cell morphology (HP:0012135): An anomaly of cells involved in the formation of a granulocytes, that is, of the granulocytopoietic cell. Evidence: TAS. (OMIM:612376)
- Typified by somatic mosaicism (HP:0001442): Description of conditions in which affected individuals typically display somatic mosaicism, i.e., genetically distinct populations of somatic cells in a given organism caused by DNA mutations, epigenetic alterations of DNA, chromosomal abnormalities or the spontaneous reversion of inherited mutations. In many conditions typified by somatic mosaicism, constitutive mutation is lethal and cases are exclusively or predominantly mosaic. Evidence: PCS. (PMID:1652368)
- Acute promyelocytic leukemia (HP:0004836): A type of acute myeloid leukemia in which abnormal promyelocytes predominate. Evidence: TAS. (OMIM:612376)